- Fourth finger symphalangism (HP:0004197): Congenital bony fusion of two adjacent phalanges of the fourth finger. Evidence: TAS. Frequency: Very frequent (HP:0040281). (ORPHA:3246)
- Fifth finger symphalangism (HP:0004218): Congenital bony fusion of two adjacent phalanges of the fifth finger. Evidence: TAS. Frequency: Very frequent (HP:0040281). (ORPHA:3246)
- Reduced proximal interphalangeal joint space (HP:0006019). Evidence: TAS. Frequency: Very frequent (HP:0040281). (ORPHA:3246)
- Macrocephaly (HP:0000256): Occipitofrontal (head) circumference greater than 97th centile compared to appropriate, age matched, sex-matched normal standards. Alternatively, a apparently increased size of the cranium. Evidence: TAS. Frequency: Frequent (HP:0040282). (ORPHA:3246)
- Absent distal interphalangeal creases (HP:0001032): Absence of the distal interphalangeal flexion creases of the fingers. Evidence: TAS. Frequency: Frequent (HP:0040282). (ORPHA:3246)
- Brachydactyly (HP:0001156): Digits that appear disproportionately short compared to the hand/foot. The word brachydactyly is used here to describe a series distinct patterns of shortened digits (brachydactyly types A-E). This is the sense used here. Evidence: TAS. Frequency: Frequent (HP:0040282). (ORPHA:3246)
- Small thenar eminence (HP:0001245): Underdevelopment of the thenar eminence with reduced palmar soft tissue mass surrounding the base of the thumb. Evidence: TAS. Frequency: Frequent (HP:0040282). (ORPHA:3246)
- Toe syndactyly (HP:0001770): Webbing or fusion of the toes, involving soft parts only or including bone structure. Bony fusions are referred to as "bony" Syndactyly if the fusion occurs in a radio-ulnar axis. Fusions of bones of the toes in a proximo-distal axis are referred to as "Symphalangism". Evidence: TAS. Frequency: Frequent (HP:0040282). (ORPHA:3246)
- Aplasia of distal finger phalanx (HP:0009881). Evidence: TAS. Frequency: Frequent (HP:0040282). (ORPHA:3246)
- Finger syndactyly (HP:0006101): Webbing or fusion of the fingers, involving soft parts only or including bone structure. Bony fusions are referred to as "bony" Syndactyly if the fusion occurs in a radio-ulnar axis. Fusions of bones of the fingers in a proximo-distal axis are referred to as "Symphalangism". Evidence: TAS. Frequency: Frequent (HP:0040282). (ORPHA:3246)
- Abnormal dermatoglyphics (HP:0007477): An abnormality of dermatoglyphs (fingerprints), which are present on fingers, palms, toes, and soles. Evidence: TAS. Frequency: Frequent (HP:0040282). (ORPHA:3246)
- Finger symphalangism (HP:0009700): An abnormal union between bones or parts of bones of the fingers. The synonymous term "symphalangism of the hand" may be translated as fusions of bones of varying digree, that involve at least one phalangeal bone of the hand. If bony fusions are referred to as "Symphalangism" the fusion occurs in a proximo-distal axis. Fusions of bones of the fingers in a radio-ulnar axis are referred to as "bony" Syndactyly. Evidence: TAS. Frequency: Frequent (HP:0040282). (ORPHA:3246)
- Toe symphalangism (HP:0010179). Evidence: TAS. Frequency: Frequent (HP:0040282). (ORPHA:3246)
- Abnormal distal toe phalanx morphology (HP:0010182). Evidence: TAS. Frequency: Frequent (HP:0040282). (ORPHA:3246)
- Small hypothenar eminence (HP:0010487): Reduced muscle mass on the ulnar side of the palm, that is, reduction in size of the hypothenar eminence. Evidence: TAS. Frequency: Frequent (HP:0040282). (ORPHA:3246)
- Clinodactyly (HP:0030084): An angulation of a digit at an interphalangeal joint in the plane of the palm (finger) or sole (toe). Evidence: TAS. Frequency: Frequent (HP:0040282). (ORPHA:3246)
- Conductive hearing impairment (HP:0000405): An abnormality of vibrational conductance of sound to the inner ear leading to impairment of sensory perception of sound. Evidence: TAS. Frequency: Occasional (HP:0040283). (ORPHA:3246)
- Abnormal palmar dermatoglyphics (HP:0001018): An abnormality of the dermatoglyphs, i.e., an abnormality of the patterns of ridges of the skin of palm of hand. Evidence: TAS. Frequency: Occasional (HP:0040283). (ORPHA:3246)
- 2-5 finger cutaneous syndactyly (HP:0005650): A soft tissue continuity in the anteroposterior axis between the second to the fifth fingers that extends distally to at least the level of the proximal interphalangeal joints. Evidence: TAS. Frequency: Occasional (HP:0040283). (ORPHA:3246)
- Abnormal finger flexion crease (HP:0006143): Anomalous flexion crease (i.e., a transverse line that crosses the skin of a finger). Evidence: TAS. Frequency: Occasional (HP:0040283). (ORPHA:3246)
- Short distal phalanx of hallux (HP:0010103): Underdevelopment (hypoplasia) of the distal phalanx of big toe. Evidence: TAS. Frequency: Occasional (HP:0040283). (ORPHA:3246)
- Aplasia/Hypoplasia of the distal phalanx of the 5th toe (HP:0100371). Evidence: TAS. Frequency: Occasional (HP:0040283). (ORPHA:3246)
These phenotypes are associated with the disease Symphalangism with multiple anomalies of hands and feet (ORPHA:3246).